- Hyporeflexia (HP:0001265): Reduction of neurologic reflexes such as the knee-jerk reaction. Evidence: IEA. (OMIM:618292)
- Epicanthus (HP:0000286): A fold of skin starting above the medial aspect of the upper eyelid and arching downward to cover, pass in front of and lateral to the medial canthus. Evidence: IEA. (OMIM:618292)
- Downslanted palpebral fissures (HP:0000494): The palpebral fissure inclination is more than two standard deviations below the mean. Evidence: PCS. Frequency: 1/2. (PMID:28195318)
- Absent speech (HP:0001344): Complete lack of development of speech and language abilities. Evidence: PCS. Frequency: 1/2. (PMID:28195318)
- Long face (HP:0000276): Facial height (length) is more than 2 standard deviations above the mean (objective); or, an apparent increase in the height (length) of the face (subjective). Evidence: PCS. Frequency: 1/2. (PMID:28195318)
- Delayed ability to walk (HP:0031936): A failure to achieve the ability to walk at an appropriate developmental stage. Most children learn to walk in a series of stages, and learn to walk short distances independently between 12 and 15 months. Evidence: PCS. Frequency: 2/2. (PMID:28195318)
- Anteverted nares (HP:0000463): Anteriorly-facing nostrils viewed with the head in the Frankfurt horizontal and the eyes of the observer level with the eyes of the subject. This gives the appearance of an upturned nose (upturned nasal tip). Evidence: IEA. (OMIM:618292)
- Gait ataxia (HP:0002066): A type of ataxia characterized by the impairment of the ability to coordinate the movements required for normal walking. Gait ataxia is characteirzed by a wide-based staggering gait with a tendency to fall. Evidence: PCS. Frequency: 2/2. (PMID:28195318)
- Hypotonia (HP:0001252): Hypotonia is an abnormally low muscle tone (the amount of tension or resistance to movement in a muscle). Even when relaxed, muscles have a continuous and passive partial contraction which provides some resistance to passive stretching. Hypotonia thus manifests as diminished resistance to passive stretching. Hypotonia is not the same as muscle weakness, although the two conditions can co-exist. Evidence: PCS. Frequency: 2/2. (PMID:28195318)
- Global developmental delay (HP:0001263): A delay in the achievement of motor or mental milestones in the domains of development of a child, including motor skills, speech and language, cognitive skills, and social and emotional skills. This term should only be used to describe children younger than five years of age. Evidence: PCS. Frequency: 2/2. (PMID:28195318)
- Infantile onset (HP:0003593): Onset of signs or symptoms of disease between 28 days to one year of life. Evidence: PCS. Frequency: 2/2. (PMID:28195318)
- Relative macrocephaly (HP:0004482): A relatively mild degree of macrocephaly in which the head circumference is not above two standard deviations from the mean, but appears dysproportionately large when other factors such as body stature are taken into account. Evidence: PCS. Frequency: 1/2. (PMID:28195318)
- Tapered finger (HP:0001182): The gradual reduction in girth of the finger from proximal to distal. Evidence: IEA. (OMIM:618292)
- Long fingers (HP:0100807): The middle finger is more than 2 SD above the mean for newborns 27 to 41 weeks EGA or above the 97th centile for children from birth to 16 years of age AND the five digits retain their normal length proportions relative to each other (i.e., it is not the case that the middle finger is the only lengthened digit), or, Fingers that appear disproportionately long compared to the palm of the hand. Evidence: PCS. Frequency: 1/2. (PMID:28195318)
- Dental malocclusion (HP:0000689): Dental malocclusion refers to an abnormality of the occlusion, or alignment, of the teeth and the way the upper and lower teeth fit together, resulting in overcrowding of teeth or in abnormal bite patterns. Evidence: PCS. Frequency: 1/2. (PMID:28195318)
- Autosomal recessive inheritance (HP:0000007): A mode of inheritance that is observed for traits related to a gene encoded on one of the autosomes (i.e., the human chromosomes 1-22) in which a trait manifests in individuals with two pathogenic alleles, either homozygotes (two copies of the same mutant allele) or compound heterozygotes (whereby each copy of a gene has a distinct mutant allele). Evidence: PCS. (PMID:28195318)
- Unsteady gait (HP:0002317). Evidence: PCS. Frequency: 1/2. (PMID:28195318)
- Pointed chin (HP:0000307): A marked tapering of the lower face to the chin. Evidence: PCS. Frequency: 1/2. (PMID:28195318)
- High palate (HP:0000218): Height of the palate more than 2 SD above the mean (objective) or palatal height at the level of the first permanent molar more than twice the height of the teeth (subjective). Evidence: PCS. Frequency: 1/2. (PMID:28195318)
- Diminished deep tendon reflex (HP:0001315): A reduction (hyporeflexia) or complete absence (areflexia) of the involuntary muscle contraction normally elicited by a reflex stimulus, such as tapping a deep tendon. Evidence: PCS. Frequency: 1/2. (PMID:28195318)
- Mandibular prognathia (HP:0000303): Abnormal prominence of the chin related to increased length of the mandible. Evidence: PCS. Frequency: 1/2. (PMID:28195318)
- Mild short stature (HP:0003502): A mild degree of short stature, more than -2 SD but not more than -3 SD from mean corrected for age and sex. Evidence: IEA. (OMIM:618292)
These phenotypes are associated with the disease neurodevelopmental disorder with impaired intellectual development, hypotonia, and ataxia (OMIM:618292).